- Progressive (HP:0003676): Applies to a disease manifestation that increases in scope or severity over the course of time, i.e., that worsens with age. Evidence: PCS. (PMID:30179222)
- Juvenile onset (HP:0003621): Onset of signs or symptoms of disease between the age of 5 and 15 years. Evidence: PCS. Frequency: 2/2. (PMID:30179222)
- Focal segmental glomerulosclerosis (HP:0000097): Segmental accumulation of scar tissue in individual (but not all) glomeruli. Evidence: PCS. Frequency: 1/2. (PMID:30179222)
- Autosomal recessive inheritance (HP:0000007): A mode of inheritance that is observed for traits related to a gene encoded on one of the autosomes (i.e., the human chromosomes 1-22) in which a trait manifests in individuals with two pathogenic alleles, either homozygotes (two copies of the same mutant allele) or compound heterozygotes (whereby each copy of a gene has a distinct mutant allele). Evidence: PCS. (PMID:30179222)
- Stage 3 chronic kidney disease (HP:0012625): A type of chronic kidney disease with moderately reduced glomerular filtration rate (GFR 30-59 mL/min/1.73 m2). Evidence: PCS. Frequency: 1/2. (PMID:30179222)
- Proteinuria (HP:0000093): Increased levels of protein in the urine. Evidence: PCS. Frequency: 2/2. (PMID:30179222)
- Steroid-resistant nephrotic syndrome (HP:0012588): A form of nephrotic syndrome that does not respond to treatment with steroid medication, defined as persistent proteinuria despite 60mg/m2 or 2mg/kg for 8 weeks, after insuring no infection or non-adherence to medication. Evidence: PCS. Frequency: 1/2. (PMID:30179222)
These phenotypes are associated with the disease nephrotic syndrome, type 19 (OMIM:618178).